Phenotypes associated with the disease Usher syndrome type 2A (OMIM:276901):
- Autosomal recessive inheritance (HP:0000007): A mode of inheritance that is observed for traits related to a gene encoded on one of the autosomes (i.e., the human chromosomes 1-22) in which a trait manifests in individuals with two pathogenic alleles, either homozygotes (two copies of the same mutant allele) or compound heterozygotes (whereby each copy of a gene has a distinct mutant allele). Evidence: IEA. (OMIM:276901)
- Rod-cone dystrophy (HP:0000510): An inherited retinal disease subtype in which the rod photoreceptors appear to be more severely affected than the cone photoreceptors. Typical presentation is with nyctalopia (due to rod dysfunction) followed by loss of mid-peripheral field of vision, which gradually extends and leaves many patients with a small central island of vision due to the preservation of macular cones. Evidence: IEA. (OMIM:276901)
- Congenital sensorineural hearing impairment (HP:0008527): A type of hearing impairment caused by an abnormal functionality of the cochlear nerve with congenital onset. Evidence: IEA. (OMIM:276901)